Phenotypes associated with the disease Alkuraya-Kucinskas syndrome (OMIM:617822):
- Small scrotum (HP:0000046): Apparently small scrotum for age. Evidence: IEA. (OMIM:617822)
- Strabismus (HP:0000486): A misalignment of the eyes so that the visual axes deviate from bifoveal fixation. The classification of strabismus may be based on a number of features including the relative position of the eyes, whether the deviation is latent or manifest, intermittent or constant, concomitant or otherwise and according to the age of onset and the relevance of any associated refractive error. Evidence: IEA. (OMIM:617822)
- Seizure (HP:0001250): A seizure is an intermittent abnormality of nervous system physiology characterized by a transient occurrence of signs and/or symptoms due to abnormal excessive or synchronous neuronal activity in the brain. Evidence: IEA. Frequency: Very rare (HP:0040284). (OMIM:617822)
- Short nose (HP:0003196): Distance from nasion to subnasale more than two standard deviations below the mean, or alternatively, an apparently decreased length from the nasal root to the nasal tip. Evidence: IEA. (OMIM:617822)
- Generalized hypotonia (HP:0001290): Generalized muscular hypotonia (abnormally low muscle tone). Evidence: IEA. (OMIM:617822)
- Kinked brainstem (HP:0012793): A kinked appearance of the brainstem, i.e., an exaggerated flexure. Evidence: IEA. (OMIM:617822)
- Cataract (HP:0000518): A cataract is an opacity or clouding that develops in the crystalline lens of the eye or in its capsule. Evidence: IEA. (OMIM:617822)
- Hypertelorism (HP:0000316): Interpupillary distance more than 2 SD above the mean (alternatively, the appearance of an increased interpupillary distance or widely spaced eyes). Evidence: IEA. (OMIM:617822)
- Overlapping toe (HP:0001845): Describes a foot digit resting on the dorsal surface of an adjacent digit when the foot is at rest. Initially clawing may be dynamic and only noticeable on walking. Over time the plantar plate tears, subluxation occurs at the metatarsophalangeal joint (MTPJ), and the deformity becomes permanent. Evidence: IEA. (OMIM:617822)
- Hydrocephalus (HP:0000238): Hydrocephalus is an active distension of the ventricular system of the brain resulting from inadequate passage of CSF from its point of production within the cerebral ventricles to its point of absorption into the systemic circulation. Evidence: PCS. Frequency: 1/1. (PMID:25558065)
- Cystic hygroma (HP:0000476): A cystic lymphatic lesion of the neck. Evidence: IEA. (OMIM:617822)
- Intellectual disability (HP:0001249): The term intellectual disability or intellectual developmental disorder is used to describe significantly sub-average intellectual and adaptive functioning based on clinical assessment and as measured by individually administered, appropriately normed, standardized and validated tests of intellectual functioning and adaptive behavior, with onset during the developmental period from infancy through adolescence. Evidence: IEA. (OMIM:617822)
- Posteriorly rotated ears (HP:0000358): A type of abnormal location of the ears in which the position of the ears is characterized by posterior rotation (the superior part of the ears is rotated towards the back of the head, and the inferior part of the ears towards the front). Evidence: IEA. (OMIM:617822)
- Hand clenching (HP:0001188): An abnormal hand posture in which the hands are clenched to fists. All digits held completely flexed at the metacarpophalangeal and interphalangeal joints. In prenatal sonography of the fetal clenched hand, the index finger overlaps a clenched fist formed by the other digits. The proximal interphalangeal articulation of the index finger is flexed and ulnarly deviated, and the thumb is adducted. Evidence: IEA. (OMIM:617822)
- Micropenis (HP:0000054): Abnormally small penis. At birth, the normal penis is about 3 cm (stretched length from pubic tubercle to tip of penis) with micropenis less than 2.0-2.5 cm. Evidence: IEA. (OMIM:617822)
- Absent speech (HP:0001344): Complete lack of development of speech and language abilities. Evidence: IEA. (OMIM:617822)
- Abnormality of eye movement (HP:0000496): An abnormality in voluntary or involuntary eye movements or their control. Evidence: IEA. (OMIM:617822)
- Global developmental delay (HP:0001263): A delay in the achievement of motor or mental milestones in the domains of development of a child, including motor skills, speech and language, cognitive skills, and social and emotional skills. This term should only be used to describe children younger than five years of age. Evidence: IEA. (OMIM:617822)
- Adducted thumb (HP:0001181): In the resting position, the tip of the thumb is on, or near, the palm, close to the base of the fourth or fifth finger. Evidence: IEA. (OMIM:617822)
- Overlapping fingers (HP:0010557): A finger resting on the dorsal surface of an adjacent digit when the hand is at rest. Evidence: IEA. (OMIM:617822)
- Camptodactyly (HP:0012385): The distal interphalangeal joint and/or the proximal interphalangeal joint of the fingers or toes cannot be extended to 180 degrees by either active or passive extension. Evidence: IEA. (OMIM:617822)
- Edema (HP:0000969): An abnormal accumulation of fluid beneath the skin, or in one or more cavities of the body. Evidence: IEA. (OMIM:617822)
- Cerebellar dysplasia (HP:0007033): Cerebellar dysplasia (abnormal growth or development) is defined by abnormal cerebellar foliation, white matter arborization, and gray-white matter junction. Cerebellar dysplasia is a neuroimaging finding that describes abnormalities of both the cerebellar cortex and white matter and is associated with variable neurodevelopmental outcome. Dysplasia may globally involve the cerebellum or affect only one cerebellar hemisphere. In addition, cerebellar dysplasia may be associated with cortical/subcortical cysts. Evidence: IEA. (OMIM:617822)
- Lissencephaly (HP:0001339): A spectrum of malformations of cortical development caused by insufficient neuronal migration that subsumes the terms agyria, pachygyria and subcortical band heterotopia. See also neuropathological definitions for 2-, 3-, and 4-layered lissencephaly. Evidence: IEA. (OMIM:617822)
- Autosomal recessive inheritance (HP:0000007): A mode of inheritance that is observed for traits related to a gene encoded on one of the autosomes (i.e., the human chromosomes 1-22) in which a trait manifests in individuals with two pathogenic alleles, either homozygotes (two copies of the same mutant allele) or compound heterozygotes (whereby each copy of a gene has a distinct mutant allele). Evidence: PCS. (PMID:25558065)
- Hypotelorism (HP:0000601): Interpupillary distance less than 2 SD below the mean (alternatively, the appearance of an decreased interpupillary distance or closely spaced eyes). Evidence: IEA. (OMIM:617822)
- Pericardial effusion (HP:0001698): Accumulation of fluid within the pericardium. Evidence: IEA. Frequency: Very rare (HP:0040284). (OMIM:617822)
- Low-set ears (HP:0000369): Upper insertion of the ear to the scalp below an imaginary horizontal line drawn between the inner canthi of the eye and extending posteriorly to the ear. Evidence: IEA. (OMIM:617822)
- Congenital onset (HP:0003577): A phenotypic abnormality that is present at birth. Evidence: IEA. (OMIM:617822)
- Upslanted palpebral fissure (HP:0000582): The palpebral fissure inclination is more than two standard deviations above the mean for age (objective); or, the inclination of the palpebral fissure is greater than typical for age. Evidence: IEA. (OMIM:617822)
- Pleural effusion (HP:0002202): The presence of an excessive amount of fluid in the pleural cavity. Evidence: PCS. Frequency: 1/1. (PMID:25558065)
- Anteverted nares (HP:0000463): Anteriorly-facing nostrils viewed with the head in the Frankfurt horizontal and the eyes of the observer level with the eyes of the subject. This gives the appearance of an upturned nose (upturned nasal tip). Evidence: IEA. (OMIM:617822)
- Hypermetropia (HP:0000540): An abnormality of refraction characterized by the ability to see objects in the distance clearly, while objects nearby appear blurry. Evidence: IEA. (OMIM:617822)
- Hypoplasia of the brainstem (HP:0002365): Underdevelopment of the brainstem. Evidence: IEA. (OMIM:617822)
- Gray matter heterotopia (HP:0002282): Heterotopia or neuronal heterotopia are macroscopic clusters of misplaced neurons (gray matter), most often situated along the ventricular walls or within the subcortical white matter. Evidence: IEA. (OMIM:617822)
- Cutaneous syndactyly (HP:0012725): A soft tissue continuity in the A/P axis between two digits that extends distally to at least the level of the proximal interphalangeal joints, or a soft tissue continuity in the A/P axis between two digits that lies significantly distal to the flexion crease that overlies the metacarpophalangeal or metatarsophalangeal joint of the adjacent digits. Evidence: IEA. (OMIM:617822)
- Oculomotor apraxia (HP:0000657): Ocular motor apraxia is a deficiency in voluntary, horizontal, lateral, fast eye movements (saccades) with retention of slow pursuit movements. The inability to follow objects visually is often compensated by head movements. There may be decreased smooth pursuit, and cancelation of the vestibulo-ocular reflex. Evidence: IEA. (OMIM:617822)
- Dandy-Walker malformation (HP:0001305): A congenital brain malformation typically characterized by incomplete formation of the cerebellar vermis, dilation of the fourth ventricle, and enlargement of the posterior fossa. In layman's terms, Dandy Walker malformation is a cyst in the cerebellum (typically symmetrical) that is involved with the fourth ventricle. This may interfere with the ability to drain cerebrospinal fluid from the brain, resulting in hydrocephalus. Dandy Walker cysts are formed during early embryonic development, while the brain forms. The cyst in the cerebellum typically has several blood vessels running through it connecting to the brain, thereby prohibiting surgical removal. Evidence: PCS. Frequency: 1/1. (PMID:25558065)
- Ventriculomegaly (HP:0002119): An increase in size of the ventricular system of the brain. Evidence: IEA. (OMIM:617822)
- Clinodactyly (HP:0030084): An angulation of a digit at an interphalangeal joint in the plane of the palm (finger) or sole (toe). Evidence: IEA. (OMIM:617822)
- High palate (HP:0000218): Height of the palate more than 2 SD above the mean (objective) or palatal height at the level of the first permanent molar more than twice the height of the teeth (subjective). Evidence: IEA. (OMIM:617822)
- Macrocephaly (HP:0000256): Occipitofrontal (head) circumference greater than 97th centile compared to appropriate, age matched, sex-matched normal standards. Alternatively, a apparently increased size of the cranium. Evidence: IEA. (OMIM:617822)
- Abnormal foot morphology (HP:0001760): An abnormality of the skeleton of foot. Evidence: IEA. (OMIM:617822)
- Talipes equinovarus (HP:0001762): Talipes equinovarus (also called clubfoot) typically has four main components: inversion and adduction of the forefoot; inversion of the heel and hindfoot; equinus (limitation of extension) of the ankle and subtalar joint; and internal rotation of the leg. Evidence: PCS. Frequency: 1/1. (PMID:25558065)
- Cerebellar hypoplasia (HP:0001321): Cerebellar hypoplasia is a descriptive term implying a cerebellum with a reduced volume, but a normal shape and is stable over time. Evidence: IEA. (OMIM:617822)
- Depressed nasal bridge (HP:0005280): Posterior positioning of the nasal root in relation to the overall facial profile for age. Evidence: IEA. (OMIM:617822)
- Atypical behavior (HP:0000708): Atypical behavior is an abnormality in a person's actions that can be controlled or modulated by the will of the individual. While abnormal behaviors can be difficult to control, they are distinct from other abnormal actions that cannot be affected by the individual's will. Evidence: IEA. (OMIM:617822)
- Aplasia/Hypoplasia of the corpus callosum (HP:0007370): Absence or underdevelopment of the corpus callosum. Evidence: IEA. (OMIM:617822)
- Arthrogryposis multiplex congenita (HP:0002804): Multiple congenital contractures in different body areas. Evidence: IEA. (OMIM:617822)
- Plagiocephaly (HP:0001357): Asymmetric head shape, which is usually a combination of unilateral occipital flattening with ipsilateral frontal prominence, leading to rhomboid cranial shape. Evidence: IEA. (OMIM:617822)
- Webbed neck (HP:0000465): Pterygium colli is a congenital skin fold that runs along the sides of the neck down to the shoulders. It involves an ectopic fibrotic facial band superficial to the trapezius muscle. Excess hair-bearing skin is also present and extends down the cervical region well beyond the normal hairline. Evidence: IEA. (OMIM:617822)
- Micrognathia (HP:0000347): Developmental hypoplasia of the mandible. Evidence: PCS. Frequency: 1/1. (PMID:25558065)